- Acute encephalopathy (HP:0006846). Evidence: PCS. Frequency: 1/1. (PMID:20832341)
- Childhood onset (HP:0011463): Onset of disease at the age of between 1 and 5 years. Evidence: PCS. Frequency: 1/1. (PMID:20832341)
- HSV encephalitis (HP:0012302): Infection of the brain parenchyma with herpes simplex virus, resulting in inflammation of the brain parenchyma with neurologic dysfunction. Evidence: PCS. Frequency: 1/1. Onset: Childhood onset (HP:0011463). (PMID:20832341)
- Autosomal dominant inheritance (HP:0000006): A mode of inheritance that is observed for traits related to a gene encoded on one of the autosomes (i.e., the human chromosomes 1-22) in which a trait manifests in heterozygotes. In the context of medical genetics, an autosomal dominant disorder is caused when a single copy of the mutant allele is present. Males and females are affected equally, and can both transmit the disorder with a risk of 50% for each child of inheriting the mutant allele. Evidence: PCS. (PMID:20832341)
These phenotypes are associated with the disease herpes simplex encephalitis, susceptibility to, 3 (OMIM:614849).